Phenotypes associated with the disease anterior segment dysgenesis 8 (OMIM:617319):
- Corneal opacity (HP:0007957): A reduction of corneal clarity. Evidence: IEA. Frequency: 0/4. (PMID:27839872)
- Persistent pupillary membrane (HP:0009917): The presence of remnants of a fetal membrane that persist as strands of tissue crossing the pupil. Evidence: PCS. Frequency: 1/4. (PMID:27839872)
- Ectopia pupillae (HP:0009918): A malposition of the pupil owing to a developmental defect of the iris. Evidence: PCS. Frequency: 4/4. (PMID:27839872)
- Iris transillumination defect (HP:0012805): Transmission of light through the iris as visualized upon slit lamp examination or infrared iris transillumination videography. The light passes through defects in the pigmentation of the iris. Evidence: PCS. Frequency: 3/4. (PMID:27839872)
- Ectopia lentis (HP:0001083): Dislocation or malposition of the crystalline lens of the eye. A partial displacement (or dislocation) of the lens is described as a subluxation of the lens, while a complete displacement is termed luxation of the lens. A complete displacement occurs if the lens is completely outside the patellar fossa of the lens, either in the anterior chamber, in the vitreous, or directly on the retina. If the lens is partially displaced but still contained within the lens space, then it is termed subluxation. Evidence: PCS. Frequency: 3/3. (PMID:27839872)
- Optic nerve dysplasia (HP:0001093): The presence of developmental dysplasia of the optic nerve. Evidence: PCS. Frequency: 1/3. (PMID:27839872)
- Iridodonesis (HP:0100693): Tremulousness of the iris on movement of the eye, occurring in subluxation of the lens. Evidence: PCS. Frequency: 3/4. (PMID:27839872)
- Microphakia (HP:0012376): Abnormal smallness of the lens. Evidence: PCS. Frequency: 1/3. (PMID:27839872)
- Cataract (HP:0000518): A cataract is an opacity or clouding that develops in the crystalline lens of the eye or in its capsule. Evidence: PCS. Frequency: 4/4. (PMID:27839872)
- Corneal stromal edema (HP:0012040): Abnormal accumulation of fluid and swelling of the stroma of cornea. Evidence: PCS. Frequency: 0/3. (PMID:27839872)
- Childhood onset (HP:0011463): Onset of disease at the age of between 1 and 5 years. Evidence: PCS. (PMID:27839872)
- Autosomal recessive inheritance (HP:0000007): A mode of inheritance that is observed for traits related to a gene encoded on one of the autosomes (i.e., the human chromosomes 1-22) in which a trait manifests in individuals with two pathogenic alleles, either homozygotes (two copies of the same mutant allele) or compound heterozygotes (whereby each copy of a gene has a distinct mutant allele). Evidence: PCS. (PMID:27839872)
- Hypoplasia of the iris (HP:0007676): Congenital underdevelopment of the iris. Evidence: PCS. Frequency: 3/4. (PMID:27839872)
- Uveal ectropion (HP:0025358): Presence of iris pigment epithelium on the anterior surface of the iris. Evidence: PCS. Frequency: 3/4. (PMID:27839872)